- Abnormal cornea morphology (HP:0000481): Any abnormality of the cornea, which is the transparent tissue at the front of the eye that covers the iris, pupil, and anterior chamber. Evidence: TAS. Frequency: Very frequent (HP:0040281). (ORPHA:67043)
- Photophobia (HP:0000613): Excessive sensitivity to light with the sensation of discomfort or pain in the eyes due to exposure to bright light. Evidence: TAS. Frequency: Very frequent (HP:0040281). (ORPHA:67043)
- Punctate opacification of the cornea (HP:0007856): Punctate opacification (reduced transparency) of the corneal stroma. Evidence: TAS. Frequency: Very frequent (HP:0040281). (ORPHA:67043)
- Abnormal corneal epithelium morphology (HP:0011495): Abnormality of the corneal epithelium, that is of the epithelial tissue that covers the front of the cornea. Evidence: TAS. Frequency: Very frequent (HP:0040281). (ORPHA:67043)
- Ocular pain (HP:0200026): An unpleasant sensation characterized by physical discomfort (such as pricking, throbbing, or aching) localized to the eye. Evidence: TAS. Frequency: Very frequent (HP:0040281). (ORPHA:67043)
- Cataract (HP:0000518): A cataract is an opacity or clouding that develops in the crystalline lens of the eye or in its capsule. Evidence: TAS. Frequency: Frequent (HP:0040282). (ORPHA:67043)
- Iris atrophy (HP:0001089): Loss of iris tissue (atrophy). Evidence: TAS. Frequency: Frequent (HP:0040282). (ORPHA:67043)
- Abnormal posterior eye segment morphology (HP:0004329). Evidence: TAS. Frequency: Frequent (HP:0040282). (ORPHA:67043)
- Anterior uveitis (HP:0012122): Inflammation of the uveal tract in which the primary site of inflammation is the anterior chamber. Evidence: TAS. Frequency: Frequent (HP:0040282). (ORPHA:67043)
- Decreased corneal sensation (HP:0012155): Reduced ability of the cornea to respond to stimulation. Evidence: TAS. Frequency: Frequent (HP:0040282). (ORPHA:67043)
- Scleritis (HP:0100532): Inflammation of the sclera. Evidence: TAS. Frequency: Frequent (HP:0040282). (ORPHA:67043)
- Corneal perforation (HP:0100583): A rupture of the cornea through which a portion of the iris protrudes. Evidence: TAS. Frequency: Frequent (HP:0040282). (ORPHA:67043)
- Abnormal anterior chamber morphology (HP:0000593): Abnormality of the anterior chamber, which is the space in the eye that is behind the cornea and in front of the iris. Evidence: TAS. Frequency: Occasional (HP:0040283). (ORPHA:67043)
- Corneal stromal edema (HP:0012040): Abnormal accumulation of fluid and swelling of the stroma of cornea. Evidence: TAS. Frequency: Occasional (HP:0040283). (ORPHA:67043)
- Corneal ulceration (HP:0012804): Disruption of the epithelial layer of the cornea with involvement of the underlying stroma. Evidence: TAS. Frequency: Occasional (HP:0040283). (ORPHA:67043)
These phenotypes are associated with the disease Amoebic keratitis (ORPHA:67043).